- Abnormal lower motor neuron morphology (HP:0002366): Any structural anomaly of the lower motor neuron. Evidence: IEA. (OMIM:607641)
- Hand muscle weakness (HP:0030237): Reduced strength of the musculature of the hand. Evidence: PCS. (PMID:12627231)
- Hand muscle atrophy (HP:0009130): Muscular atrophy involving the muscles of the hand. Evidence: PCS. (PMID:12627231)
- Distal amyotrophy (HP:0003693): Muscular atrophy affecting muscles in the distal portions of the extremities. Evidence: PCS. (PMID:12627231)
- Lower limb muscle weakness (HP:0007340): Weakness of the muscles of the legs. Evidence: IEA. (OMIM:607641)
- Adult onset (HP:0003581): Onset of disease manifestations in adulthood, defined here as at the age of 16 years or later. Evidence: PCS. (PMID:12627231)
- Distal muscle weakness (HP:0002460): Reduced strength of the musculature of the distal extremities. Evidence: PCS. (PMID:12627231)
- Vocal cord paralysis (HP:0001605): A loss of the ability to move the vocal folds. Evidence: PCS. (PMID:12627231)
- Weakness of facial musculature (HP:0030319): Reduced strength of one or more muscles innervated by the facial nerve (the seventh cranial nerve). Evidence: PCS. (PMID:12627231)
- Slowly progressive (HP:0003677): Applies to a disease manifestation that only slowly increases in scope or severity over the course of time. Evidence: PCS. (PMID:12627231)
- Autosomal dominant inheritance (HP:0000006): A mode of inheritance that is observed for traits related to a gene encoded on one of the autosomes (i.e., the human chromosomes 1-22) in which a trait manifests in heterozygotes. In the context of medical genetics, an autosomal dominant disorder is caused when a single copy of the mutant allele is present. Males and females are affected equally, and can both transmit the disorder with a risk of 50% for each child of inheriting the mutant allele. Evidence: PCS. (PMID:12627231)
These phenotypes are associated with the disease neuronopathy, distal hereditary motor, type 7B (OMIM:607641).